- Headache (HP:0002315, a Human Phenotype Ontology term): Cephalgia, or pain sensed in various parts of the head, not confined to the area of distribution of any nerve. Evidence: TAS. Frequency: Very frequent (HP:0040281, a Human Phenotype Ontology term). (ORPHA:74)
- CSF pleocytosis (HP:0012229, a Human Phenotype Ontology term): An increased white blood cell count in the cerebrospinal fluid. Evidence: TAS. Frequency: Very frequent (HP:0040281, a Human Phenotype Ontology term). (ORPHA:74)
- Severely increased total eosinophil count (HP:0032061, a Human Phenotype Ontology term): Severe increase in circulating eosinophils, usually characterized as more than 1500 eosinophils per microlitre. Evidence: TAS. Frequency: Very frequent (HP:0040281, a Human Phenotype Ontology term). (ORPHA:74)
- Diplopia (HP:0000651, a Human Phenotype Ontology term): Diplopia is a condition in which a single object is perceived as two images, it is also known as double vision. Evidence: TAS. Frequency: Frequent (HP:0040282, a Human Phenotype Ontology term). (ORPHA:74)
- Irritability (HP:0000737, a Human Phenotype Ontology term): An emotional state characterized by negative feelings of heightened frustration, annoyance, or feeling upset, often triggered by internal factors (e.g., fatigue, hunger, unfulfilled desires) or external factors (e.g., social or environmental challenges). Irritability may be unpredictable, and is accompanied by a lowered threshold for emotional reactivity and observable features (speech, facial expressions, or psychomotor activity). Evidence: TAS. Frequency: Frequent (HP:0040282, a Human Phenotype Ontology term). (ORPHA:74)
- Excessive daytime somnolence (HP:0001262, a Human Phenotype Ontology term): A state of abnormally strong desire for sleep during the daytime. Evidence: TAS. Frequency: Frequent (HP:0040282, a Human Phenotype Ontology term). (ORPHA:74)
- Meningitis (HP:0001287, a Human Phenotype Ontology term): Inflammation of the meninges. Evidence: TAS. Frequency: Frequent (HP:0040282, a Human Phenotype Ontology term). (ORPHA:74)
- Fever (HP:0001945, a Human Phenotype Ontology term): Body temperature elevated above the normal range. Evidence: TAS. Frequency: Frequent (HP:0040282, a Human Phenotype Ontology term). (ORPHA:74)
- Vomiting (HP:0002013, a Human Phenotype Ontology term): Forceful ejection of the contents of the stomach through the mouth by means of a series of involuntary spasmic contractions. Evidence: TAS. Frequency: Frequent (HP:0040282, a Human Phenotype Ontology term). (ORPHA:74)
- Constipation (HP:0002019, a Human Phenotype Ontology term): Infrequent or difficult evacuation of feces. Evidence: TAS. Frequency: Frequent (HP:0040282, a Human Phenotype Ontology term). (ORPHA:74)
- Abdominal pain (HP:0002027, a Human Phenotype Ontology term): An unpleasant sensation characterized by physical discomfort (such as pricking, throbbing, or aching) and perceived to originate in the abdomen. Evidence: TAS. Frequency: Frequent (HP:0040282, a Human Phenotype Ontology term). (ORPHA:74)
- Increased intracranial pressure (HP:0002516, a Human Phenotype Ontology term): An increase of the pressure inside the cranium (skull) and thereby in the brain tissue and cerebrospinal fluid. Evidence: TAS. Frequency: Frequent (HP:0040282, a Human Phenotype Ontology term). (ORPHA:74)
- Projectile vomiting (HP:0002587, a Human Phenotype Ontology term): Vomiting that ejects the gastric contents with great force. Evidence: TAS. Frequency: Frequent (HP:0040282, a Human Phenotype Ontology term). (ORPHA:74)
- Arthralgia (HP:0002829, a Human Phenotype Ontology term): Joint pain. Evidence: TAS. Frequency: Frequent (HP:0040282, a Human Phenotype Ontology term). (ORPHA:74)
- Myalgia (HP:0003326, a Human Phenotype Ontology term): Pain in muscle. Evidence: TAS. Frequency: Frequent (HP:0040282, a Human Phenotype Ontology term). (ORPHA:74)
- Paresthesia (HP:0003401, a Human Phenotype Ontology term): Abnormal sensations such as tingling, pricking, or numbness of the skin with no apparent physical cause. Evidence: TAS. Frequency: Frequent (HP:0040282, a Human Phenotype Ontology term). (ORPHA:74)
- Poor appetite (HP:0004396, a Human Phenotype Ontology term): A reduced desire to eat. Evidence: TAS. Frequency: Frequent (HP:0040282, a Human Phenotype Ontology term). (ORPHA:74)
- Unusual CNS infection (HP:0011450, a Human Phenotype Ontology term): Increased susceptibility to infections of the central nervous system, as manifested by recurrent, severe, or invasive infections involving the brain, meninges, or spinal cord. This can include infections caused by opportunistic or atypical pathogens, or common pathogens presenting with unusual severity or in anatomical locations. Evidence: TAS. Frequency: Frequent (HP:0040282, a Human Phenotype Ontology term). (ORPHA:74)
- Fatigue (HP:0012378, a Human Phenotype Ontology term): A subjective feeling of tiredness characterized by a lack of energy and motivation. Evidence: TAS. Frequency: Frequent (HP:0040282, a Human Phenotype Ontology term). (ORPHA:74)
- Stiff neck (HP:0025258, a Human Phenotype Ontology term): A sensation of tightness in the neck when attempting to move it, especially after a period of inactivity. Neck stiffness often involves soreness and difficulty moving the neck, especially when trying to turn the head to the side. Evidence: TAS. Frequency: Frequent (HP:0040282, a Human Phenotype Ontology term). (ORPHA:74)
- Gastrointestinal eosinophilia (HP:0032064, a Human Phenotype Ontology term): Eosinophilic infiltration of one or more gastrointestinal organs. Gastrointestinal eosinophilia is a broad term for abnormal eosinophil accumulation in the GI tract, involving many different disease identities. These diseases include primary eosinophil associated gastrointestinal diseases, gastrointestinal eosinophilia in HES and all gastrointestinal eosinophilic states associated with known causes. Each of these diseases has its unique features but there is no absolute boundary between them. Evidence: TAS. Frequency: Frequent (HP:0040282, a Human Phenotype Ontology term). (ORPHA:74)
- Brain imaging abnormality (HP:0410263, a Human Phenotype Ontology term): An anomaly of metabolism or structure of the brain identified by imaging. Evidence: TAS. Frequency: Frequent (HP:0040282, a Human Phenotype Ontology term). (ORPHA:74)
- Blurred vision (HP:0000622, a Human Phenotype Ontology term): Lack of sharpness of vision resulting in the inability to see fine detail. Evidence: TAS. Frequency: Occasional (HP:0040283, a Human Phenotype Ontology term). (ORPHA:74)
- Pruritus (HP:0000989, a Human Phenotype Ontology term): Pruritus is an itch or a sensation that makes a person want to scratch. This term refers to an abnormally increased disposition to experience pruritus. Evidence: TAS. Frequency: Occasional (HP:0040283, a Human Phenotype Ontology term). (ORPHA:74)
- Seizure (HP:0001250, a Human Phenotype Ontology term): A seizure is an intermittent abnormality of nervous system physiology characterized by a transient occurrence of signs and/or symptoms due to abnormal excessive or synchronous neuronal activity in the brain. Evidence: TAS. Frequency: Occasional (HP:0040283, a Human Phenotype Ontology term). (ORPHA:74)
- Muscle weakness (HP:0001324, a Human Phenotype Ontology term): Reduced strength of muscles. Evidence: TAS. Frequency: Occasional (HP:0040283, a Human Phenotype Ontology term). (ORPHA:74)
- Nausea (HP:0002018, a Human Phenotype Ontology term): A sensation of unease in the stomach together with an urge to vomit. Evidence: TAS. Frequency: Occasional (HP:0040283, a Human Phenotype Ontology term). (ORPHA:74)
- Ventriculomegaly (HP:0002119, a Human Phenotype Ontology term): An increase in size of the ventricular system of the brain. Evidence: TAS. Frequency: Occasional (HP:0040283, a Human Phenotype Ontology term). (ORPHA:74)
- Cerebral edema (HP:0002181, a Human Phenotype Ontology term): Abnormal accumulation of fluid in the brain. Evidence: TAS. Frequency: Occasional (HP:0040283, a Human Phenotype Ontology term). (ORPHA:74)
- Distal muscle weakness (HP:0002460, a Human Phenotype Ontology term): Reduced strength of the musculature of the distal extremities. Evidence: TAS. Frequency: Occasional (HP:0040283, a Human Phenotype Ontology term). (ORPHA:74)
- Increased circulating IgG concentration (HP:0003237, a Human Phenotype Ontology term): An abnormally increased level of immunoglobulin G in blood. Evidence: TAS. Frequency: Occasional (HP:0040283, a Human Phenotype Ontology term). (ORPHA:74)
- Increased circulating IgA concentration (HP:0003261, a Human Phenotype Ontology term): An abnormally increased level of immunoglobulin A in blood. Evidence: TAS. Frequency: Occasional (HP:0040283, a Human Phenotype Ontology term). (ORPHA:74)
- Increased circulating IgM concentration (HP:0003496, a Human Phenotype Ontology term): An abnormally increased level of immunoglobulin M in blood. Evidence: TAS. Frequency: Occasional (HP:0040283, a Human Phenotype Ontology term). (ORPHA:74)
- Pain (HP:0012531, a Human Phenotype Ontology term): An unpleasant sensory and emotional experience associated with actual or potential tissue damage, or described in terms of such damage. Evidence: TAS. Frequency: Occasional (HP:0040283, a Human Phenotype Ontology term). (ORPHA:74)
- Neck pain (HP:0030833, a Human Phenotype Ontology term): An unpleasant sensation characterized by physical discomfort (such as pricking, throbbing, or aching) localized to the neck. Evidence: TAS. Frequency: Occasional (HP:0040283, a Human Phenotype Ontology term). (ORPHA:74)
- Nuchal rigidity (HP:0031179, a Human Phenotype Ontology term): Resistance of the extensor muscles of the neck to being bent forwards (i.e., impaired neck flexion) as a result of muscle spasm of the extensor muscles of the neck. Nuchal rigidity is not a fixed rigidity. Nuchal rigidity has been used as a bedside test for meningism, although its sensitivity for this purpose has been debated. Evidence: TAS. Frequency: Occasional (HP:0040283, a Human Phenotype Ontology term). (ORPHA:74)
- Increased circulating specific IgE antibody concentration (HP:0032336, a Human Phenotype Ontology term). Evidence: TAS. Frequency: Occasional (HP:0040283, a Human Phenotype Ontology term). (ORPHA:74)
- Coma (HP:0001259, a Human Phenotype Ontology term): The complete absence of wakefulness and consciousness, which is evident through a lack of response to any form of external stimuli. Evidence: TAS. Frequency: Very rare (HP:0040284, a Human Phenotype Ontology term). (ORPHA:74)
- Hyperesthesia (HP:0100963, a Human Phenotype Ontology term): Increased sensitivity to stimulation, excluding the special senses, which may refer to various modes of cutaneous sensibility including touch and thermal sensation without pain, as well as to pain. Evidence: TAS. Frequency: Very rare (HP:0040284, a Human Phenotype Ontology term). (ORPHA:74)
These phenotypes are associated with the disease Angiostrongyliasis (ORPHA:74, an Orphanet rare-disease identifier).